Phenotypes associated with the disease pyknoachondrogenesis (OMIM:265880):
- Increased bone mineral density (HP:0011001): An abnormal increase of bone mineral density, that is, of the amount of matter per cubic centimeter of bones which is often referred to as osteosclerosis. Osteosclerosis can be detected on radiological examination as an increased whiteness (density) of affected bones. Evidence: IEA. (OMIM:265880)
- Stillbirth (HP:0003826): Death of the fetus in utero after at least 22 weeks of gestation. Evidence: TAS. (OMIM:265880)
- Autosomal recessive inheritance (HP:0000007): A mode of inheritance that is observed for traits related to a gene encoded on one of the autosomes (i.e., the human chromosomes 1-22) in which a trait manifests in individuals with two pathogenic alleles, either homozygotes (two copies of the same mutant allele) or compound heterozygotes (whereby each copy of a gene has a distinct mutant allele). Evidence: IEA. (OMIM:265880)